Phenotypes associated with the disease Submucosal cleft palate (ORPHA:155878):
- Bifid uvula (HP:0000193): Uvula separated into two parts most easily seen at the tip. Evidence: TAS. Frequency: Frequent (HP:0040282). (ORPHA:155878)
- Hypernasal speech (HP:0001611): A type of speech characterized by the presence of an abnormally increased nasal airflow during speech associated with structural abnormality of the nasal passages. Evidence: TAS. Frequency: Frequent (HP:0040282). (ORPHA:155878)
- Nasal regurgitation (HP:0011469): Regurgitation of milk through the nose. Evidence: TAS. Frequency: Frequent (HP:0040282). (ORPHA:155878)
- Submucous cleft palate (HP:5201016): A cleft of the muscular portion of the palate that is covered by mucous membrane. Evidence: TAS. Frequency: Frequent (HP:0040282). (ORPHA:155878)
- Hearing impairment (HP:0000365): A decreased magnitude of the sensory perception of sound. Evidence: TAS. Frequency: Occasional (HP:0040283). (ORPHA:155878)
- Recurrent otitis media (HP:0000403): Increased susceptibility to otitis media, as manifested by recurrent episodes of otitis media. Evidence: TAS. Frequency: Occasional (HP:0040283). (ORPHA:155878)